- Large forehead (HP:0002003). Evidence: PCS. Frequency: 2/4. (PMID:21594994)
- Epicanthus (HP:0000286): A fold of skin starting above the medial aspect of the upper eyelid and arching downward to cover, pass in front of and lateral to the medial canthus. Evidence: PCS. Frequency: 1/4. (PMID:21594994)
- Astigmatism (HP:0000483): A type of refraction error associated with abnormal curvatures on the anterior and/or posterior surface of the cornea. Evidence: PCS. Frequency: 2/4. (PMID:21594994)
- Long philtrum (HP:0000343): Distance between nasal base and midline upper lip vermilion border more than 2 SD above the mean. Alternatively, an apparently increased distance between nasal base and midline upper lip vermilion border. Evidence: PCS. Frequency: 2/4. (PMID:21594994)
- Strabismus (HP:0000486): A misalignment of the eyes so that the visual axes deviate from bifoveal fixation. The classification of strabismus may be based on a number of features including the relative position of the eyes, whether the deviation is latent or manifest, intermittent or constant, concomitant or otherwise and according to the age of onset and the relevance of any associated refractive error. Evidence: PCS. Frequency: 4/4. (PMID:21594994)
- Hypermetropia (HP:0000540): An abnormality of refraction characterized by the ability to see objects in the distance clearly, while objects nearby appear blurry. Evidence: PCS. Frequency: 2/4. (PMID:21594994)
- Seizure (HP:0001250): A seizure is an intermittent abnormality of nervous system physiology characterized by a transient occurrence of signs and/or symptoms due to abnormal excessive or synchronous neuronal activity in the brain. Evidence: PCS. Frequency: 1/4. (PMID:21594994)
- Hypotonia (HP:0001252): Hypotonia is an abnormally low muscle tone (the amount of tension or resistance to movement in a muscle). Even when relaxed, muscles have a continuous and passive partial contraction which provides some resistance to passive stretching. Hypotonia thus manifests as diminished resistance to passive stretching. Hypotonia is not the same as muscle weakness, although the two conditions can co-exist. Evidence: PCS. Frequency: 1/4. (PMID:21594994)
- Coarse facial features (HP:0000280): Absence of fine and sharp appearance of brows, nose, lips, mouth, and chin, usually because of rounded and heavy features or thickened skin with or without thickening of subcutaneous and bony tissues. Evidence: PCS. Frequency: 4/4. (PMID:21594994)
- Flat face (HP:0012368): Absence of concavity or convexity of the face when viewed in profile. Evidence: PCS. Frequency: 2/4. (PMID:21594994)
- Ventricular septal defect (HP:0001629): A hole between the two bottom chambers (ventricles) of the heart. The defect is centered around the most superior aspect of the ventricular septum. Evidence: PCS. Frequency: 1/4. (PMID:21594994)
- Hypertelorism (HP:0000316): Interpupillary distance more than 2 SD above the mean (alternatively, the appearance of an increased interpupillary distance or widely spaced eyes). Evidence: PCS. Frequency: 2/4. (PMID:21594994)
- Long fingers (HP:0100807): The middle finger is more than 2 SD above the mean for newborns 27 to 41 weeks EGA or above the 97th centile for children from birth to 16 years of age AND the five digits retain their normal length proportions relative to each other (i.e., it is not the case that the middle finger is the only lengthened digit), or, Fingers that appear disproportionately long compared to the palm of the hand. Evidence: TAS. (OMIM:615668)
- Long palpebral fissure (HP:0000637): Distance between medial and lateral canthi is more than two standard deviations above the mean for age (objective); or, apparently increased length of the palpebral fissures. Evidence: TAS. (OMIM:615668)
- Postnatal growth retardation (HP:0008897): Slow or limited growth after birth. Evidence: PCS. Frequency: 3/4. (PMID:21594994)
- Hypotension (HP:0002615): Low Blood Pressure, vascular hypotension. Evidence: TAS. (OMIM:615668)
- Low hanging columella (HP:0009765): Columella extending inferior to the level of the nasal base, when viewed from the side. Evidence: TAS. (OMIM:615668)
- Patent ductus arteriosus (HP:0001643): In utero, the ductus arteriosus (DA) serves to divert ventricular output away from the lungs and toward the placenta by connecting the main pulmonary artery to the descending aorta. A patent ductus arteriosus (PDA) in the first 3 days of life is a physiologic shunt in healthy term and preterm newborn infants, and normally is substantially closed within about 24 hours after bith and completely closed after about three weeks. Failure of physiologcal closure is referred to a persistent or patent ductus arteriosus (PDA). Depending on the degree of left-to-right shunting, PDA can have clinical consequences. Evidence: PCS. Frequency: 1/4. (PMID:21594994)
- Macroglossia (HP:0000158): Increased length and width of the tongue. Evidence: PCS. Frequency: 1/4. (PMID:21594994)
- Intellectual disability (HP:0001249): The term intellectual disability or intellectual developmental disorder is used to describe significantly sub-average intellectual and adaptive functioning based on clinical assessment and as measured by individually administered, appropriately normed, standardized and validated tests of intellectual functioning and adaptive behavior, with onset during the developmental period from infancy through adolescence. Evidence: TAS. (OMIM:615668)
- Posteriorly rotated ears (HP:0000358): A type of abnormal location of the ears in which the position of the ears is characterized by posterior rotation (the superior part of the ears is rotated towards the back of the head, and the inferior part of the ears towards the front). Evidence: TAS. (OMIM:615668)
- Wide mouth (HP:0000154): Distance between the oral commissures more than 2 SD above the mean. Alternatively, an apparently increased width of the oral aperture (subjective). Evidence: PCS. Frequency: 1/4. (PMID:21594994)
- Overfolded helix (HP:0000396): A condition in which the helix is folded over to a greater degree than normal. That is, excessive curling of the helix edge, whereby the free edge is parallel to the plane of the ear. Evidence: PCS. Frequency: 1/4. (PMID:21594994)
- Decreased body mass index (HP:0045082): Abnormally decreased weight-to-height squared ratio, calculated by dividing the individual's weight in kilograms by the square of the individual's height in meters and used as an indicator of underweight compared to averages. Evidence: TAS. (OMIM:615668)
- Delayed speech and language development (HP:0000750): A degree of language development that is significantly below the norm for a child of a specified age. Evidence: TAS. (OMIM:615668)
- Short chin (HP:0000331): Decreased vertical distance from the vermilion border of the lower lip to the inferior-most point of the chin. Evidence: TAS. (OMIM:615668)
- Febrile seizure (within the age range of 3 months to 6 years) (HP:0002373): A febrile seizure is any type of seizure (most often a generalized tonic-clonic seizure) occurring with fever (at least 38 degrees Celsius) but in the absence of central nervous system infection, severe metabolic disturbance or other alternative precipitant in children between the ages of 3 months and 6 years. Evidence: PCS. Frequency: 1/4. (PMID:21594994)
- Global developmental delay (HP:0001263): A delay in the achievement of motor or mental milestones in the domains of development of a child, including motor skills, speech and language, cognitive skills, and social and emotional skills. This term should only be used to describe children younger than five years of age. Evidence: PCS. Frequency: 4/4. (PMID:21594994)
- Short neck (HP:0000470): Diminished length of the neck. Evidence: PCS. Frequency: 2/4. (PMID:21594994)
- Long toe (HP:0010511): Toes that appear disproportionately long compared to the foot. Evidence: TAS. (OMIM:615668)
- Disproportionate tall stature (HP:0001519): A tall and slim body build with increased arm span to height ratio (>1.05) and a reduced upper-to-lower segment ratio (<0.85), i.e., unusually long arms and legs. The extremities as well as the hands and feet are unusually slim. Evidence: TAS. (OMIM:615668)
- Increased nuchal translucency (HP:0010880): Nuchal translucency is the sonographic appearance of subcutaneous accumulation of liquid in the back of the fetal neck in the first trimester of pregnancy (11-14 gestational weeks of pregnancy). Evidence: PCS. Frequency: 1/4. (PMID:21594994)
- Ptosis (HP:0000508): The upper eyelid margin is positioned 3 mm or more lower than usual and covers the superior portion of the iris (objective); or, the upper lid margin obscures at least part of the pupil (subjective). Evidence: PCS. Frequency: 3/4. (PMID:21594994)
- Prominent nose (HP:0000448): Distance between subnasale and pronasale more than two standard deviations above the mean, or alternatively, an apparently increased anterior protrusion of the nasal tip. Evidence: TAS. (OMIM:615668)
- Visual impairment (HP:0000505): Visual impairment (or vision impairment) is vision loss (of a person) to such a degree as to qualify as an additional support need through a significant limitation of visual capability resulting from either disease, trauma, or congenital or degenerative conditions that cannot be corrected by conventional means, such as refractive correction, medication, or surgery. Evidence: PCS. Frequency: 3/4. (PMID:21594994)
- Esotropia (HP:0000565): A form of strabismus with one or both eyes turned inward ('crossed') to a relatively severe degree, usually defined as 10 diopters or more. Evidence: TAS. (OMIM:615668)
- Frontal bossing (HP:0002007): Bilateral bulging of the lateral frontal bone prominences with relative sparing of the midline. Evidence: PCS. Frequency: 1/4. (PMID:21594994)
- Atrial septal defect (HP:0001631): Atrial septal defect (ASD) is a congenital abnormality of the interatrial septum that enables blood flow between the left and right atria via the interatrial septum. Evidence: PCS. Frequency: 1/4. (PMID:21594994)
- Short philtrum (HP:0000322): Distance between nasal base and midline upper lip vermilion border more than 2 SD below the mean. Alternatively, an apparently decreased distance between nasal base and midline upper lip vermilion border. Evidence: PCS. Frequency: 1/4. (PMID:21594994)
- Sacral dimple (HP:0000960): A cutaneous indentation resulting from tethering of the skin to underlying structures (bone) of the intergluteal cleft. Evidence: PCS. Frequency: 1/4. (PMID:21594994)
- Autosomal dominant inheritance (HP:0000006): A mode of inheritance that is observed for traits related to a gene encoded on one of the autosomes (i.e., the human chromosomes 1-22) in which a trait manifests in heterozygotes. In the context of medical genetics, an autosomal dominant disorder is caused when a single copy of the mutant allele is present. Males and females are affected equally, and can both transmit the disorder with a risk of 50% for each child of inheriting the mutant allele. Evidence: PCS. (PMID:21594994)
- Micrognathia (HP:0000347): Developmental hypoplasia of the mandible. Evidence: PCS. Frequency: 1/4. (PMID:21594994)
- Patent foramen ovale (HP:0001655): Failure of the foramen ovale to seal postnatally, leaving a potential conduit between the left and right cardiac atria. Evidence: PCS. Frequency: 1/4. (PMID:21594994)
These phenotypes are associated with the disease chromosome 5q12 deletion syndrome (OMIM:615668).